Phenotypes associated with the disease Nephrosis-deafness-urinary tract-digital malformations syndrome (ORPHA:2669):
- Abnormality of the urinary system (HP:0000079): An abnormality of the urinary system. Evidence: TAS. Frequency: Frequent (HP:0040282). (ORPHA:2669)
- Hydronephrosis (HP:0000126): Severe distention of the kidney with dilation of the renal pelvis and calices. Evidence: TAS. Frequency: Frequent (HP:0040282). (ORPHA:2669)
- Bifid uvula (HP:0000193): Uvula separated into two parts most easily seen at the tip. Evidence: TAS. Frequency: Frequent (HP:0040282). (ORPHA:2669)
- Conductive hearing impairment (HP:0000405): An abnormality of vibrational conductance of sound to the inner ear leading to impairment of sensory perception of sound. Evidence: TAS. Frequency: Frequent (HP:0040282). (ORPHA:2669)
- Abnormal thumb morphology (HP:0001172): An abnormal structure of the first digit of the hand. Evidence: TAS. Frequency: Frequent (HP:0040282). (ORPHA:2669)
- Maternal hypertension (HP:0008071): Increased blood pressure during a pregnancy. Evidence: TAS. Frequency: Frequent (HP:0040282). (ORPHA:2669)
- Bifid distal phalanx of the thumb (HP:0009611): Partial duplication of the distal phalanx of the thumb. Depending on the severity, the appearance on x-ray can vary from a notched phalanx (the duplicated bone is almost completely fused with the phalanx) to a partially fused appearance of the two bones. Evidence: TAS. Frequency: Frequent (HP:0040282). (ORPHA:2669)
- Broad hallux (HP:0010055): Visible increase in width of the hallux without an increase in the dorso-ventral dimension. Evidence: TAS. Frequency: Frequent (HP:0040282). (ORPHA:2669)
- Partial duplication of the distal phalanx of the hallux (HP:0010097). Evidence: TAS. Frequency: Frequent (HP:0040282). (ORPHA:2669)